- Aphasia (HP:0002381): An acquired language impairment of some or all of the abilities to produce or comprehend speech and to read or write. Evidence: TAS. Frequency: Very frequent (HP:0040281). (ORPHA:1799)
- Expressive language delay (HP:0002474): A delay in the acquisition of the ability to use language to communicate needs, wishes, or thoughts. Evidence: TAS. Frequency: Very frequent (HP:0040281). (ORPHA:1799)
- Incomprehensible speech (HP:0002546). Evidence: TAS. Frequency: Very frequent (HP:0040281). (ORPHA:1799)
These phenotypes are associated with the disease Familial developmental dysphasia (ORPHA:1799).